- Visual impairment (HP:0000505): Visual impairment (or vision impairment) is vision loss (of a person) to such a degree as to qualify as an additional support need through a significant limitation of visual capability resulting from either disease, trauma, or congenital or degenerative conditions that cannot be corrected by conventional means, such as refractive correction, medication, or surgery. Evidence: TAS. Frequency: Very frequent (HP:0040281). (ORPHA:1873)
- Color vision defect (HP:0000551): An anomaly in the ability to discriminate between or recognize colors. Evidence: TAS. Frequency: Very frequent (HP:0040281). (ORPHA:1873)
- Photophobia (HP:0000613): Excessive sensitivity to light with the sensation of discomfort or pain in the eyes due to exposure to bright light. Evidence: TAS. Frequency: Very frequent (HP:0040281). (ORPHA:1873)
- Nystagmus (HP:0000639): Rhythmic, involuntary oscillations of one or both eyes related to abnormality in fixation, conjugate gaze, or vestibular mechanisms. Evidence: TAS. Frequency: Very frequent (HP:0040281). (ORPHA:1873)
- Optic atrophy (HP:0000648): Atrophy of the optic nerve. Optic atrophy results from the death of the retinal ganglion cell axons that comprise the optic nerve and manifesting as a pale optic nerve on fundoscopy. Evidence: TAS. Frequency: Frequent (HP:0040282). (ORPHA:1873)
- Abnormal dental enamel morphology (HP:0000682): An abnormality of the dental enamel. Evidence: TAS. Frequency: Very frequent (HP:0040281). (ORPHA:1873)
- Amelogenesis imperfecta (HP:0000705): A developmental dysplasia of the dental enamel. Evidence: TAS. Frequency: Very frequent (HP:0040281). (ORPHA:1873)
- Abnormal retinal pigmentation (HP:0007703): Any deviation from the normal pigmentation of the retina. Evidence: TAS. Frequency: Very frequent (HP:0040281). (ORPHA:1873)
- Abnormality of dental color (HP:0011073): A developmental defect of tooth color. Evidence: TAS. Frequency: Very frequent (HP:0040281). (ORPHA:1873)
These phenotypes are associated with the disease Jalili syndrome (ORPHA:1873).